- Hyposmia (HP:0004409): A decreased sensitivity to odorants (that is, a decreased ability to perceive odors). Evidence: PCS. (PMID:22152683)
- Conductive hearing impairment (HP:0000405): An abnormality of vibrational conductance of sound to the inner ear leading to impairment of sensory perception of sound. Evidence: PCS. (PMID:22152683)
- Atresia of the external auditory canal (HP:0000413): Absence or failure to form of the external auditory canal. Evidence: PCS. (PMID:22152683)
- Autosomal dominant inheritance (HP:0000006): A mode of inheritance that is observed for traits related to a gene encoded on one of the autosomes (i.e., the human chromosomes 1-22) in which a trait manifests in heterozygotes. In the context of medical genetics, an autosomal dominant disorder is caused when a single copy of the mutant allele is present. Males and females are affected equally, and can both transmit the disorder with a risk of 50% for each child of inheriting the mutant allele. Evidence: PCS. (PMID:22152683)
These phenotypes are associated with the disease aural atresia, congenital (OMIM:607842).